- Microcephaly (HP:0000252): Head circumference below 2 standard deviations below the mean for age and gender. Evidence: PCS. Frequency: 2/5. (PMID:28584052;PMID:28302723)
- Open mouth (HP:0000194): A facial appearance characterized by a permanently or nearly permanently opened mouth. Evidence: PCS. Frequency: 2/3. (PMID:28302723)
- Global developmental delay (HP:0001263): A delay in the achievement of motor or mental milestones in the domains of development of a child, including motor skills, speech and language, cognitive skills, and social and emotional skills. This term should only be used to describe children younger than five years of age. Evidence: PCS. Frequency: 2/2. (PMID:28584052)
- Nystagmus (HP:0000639): Rhythmic, involuntary oscillations of one or both eyes related to abnormality in fixation, conjugate gaze, or vestibular mechanisms. Evidence: PCS. Frequency: 1/2. (PMID:28584052)
- X-linked recessive inheritance (HP:0001419): A mode of inheritance that is observed for recessive traits related to a gene encoded on the X chromosome. In the context of medical genetics, X-linked recessive disorders manifest in males (who have one copy of the X chromosome and are thus hemizygotes), but generally not in female heterozygotes who have one mutant and one normal allele. Evidence: PCS. (PMID:28302723)
- Thick vermilion border (HP:0012471): Increased width of the skin of vermilion border region of upper lip. Evidence: PCS. Frequency: 2/2. (PMID:28584052)
- Amblyopia (HP:0000646): Reduced visual acuity that is uncorrectable by lenses in the absence of detectable anatomic defects in the eye or visual pathways. Evidence: PCS. Frequency: 1/2. (PMID:28584052)
- High hypermetropia (HP:0008499): A severe form of hypermetropia with over +5.00 diopters. Evidence: PCS. Frequency: 1/2. (PMID:28584052)
- Hypertelorism (HP:0000316): Interpupillary distance more than 2 SD above the mean (alternatively, the appearance of an increased interpupillary distance or widely spaced eyes). Evidence: PCS. Frequency: 2/2. (PMID:28584052)
- Bicuspid aortic valve (HP:0001647): The presence of an aortic valve with two instead of the normal three cusps (flaps). Bicuspid aortic valvue is a malformation of a commissure (small space between the attachment of each cusp to the aortic wall) and the adjacent parts of the two corresponding cusps forming a raphe (the fused area of the two underdeveloped cusps turning into a malformed commissure between both cusps; the raphe is a fibrous ridge that extends from the commissure to the free edge of the two underdeveloped, conjoint cusps). Evidence: PCS. Frequency: 1/2. (PMID:28584052)
- Thin upper lip vermilion (HP:0000219): Height of the vermilion of the upper lip in the midline more than 2 SD below the mean. Alternatively, an apparently reduced height of the vermilion of the upper lip in the frontal view (subjective). Evidence: PCS. Frequency: 1/3. (PMID:28302723)
- Clinodactyly of the 5th finger (HP:0004209): Clinodactyly refers to a bending or curvature of the fifth finger in the radial direction (i.e., towards the 4th finger). Evidence: PCS. Frequency: 3/3. (PMID:28302723)
- Clinodactyly (HP:0030084): An angulation of a digit at an interphalangeal joint in the plane of the palm (finger) or sole (toe). Evidence: PCS. Frequency: 2/2. (PMID:28584052)
- Decreased testicular size (HP:0008734): Reduced volume of the testicle (the male gonad). Evidence: PCS. Frequency: 1/3. (PMID:28302723)
- Synophrys (HP:0000664): Meeting of the medial eyebrows in the midline. Evidence: PCS. Frequency: 1/3. (PMID:28302723)
- Hypospadias (HP:0000047): Abnormal position of urethral meatus on the ventral penile shaft (underside) characterized by displacement of the urethral meatus from the tip of the glans penis to the ventral surface of the penis, scrotum, or perineum. Evidence: PCS. Frequency: 2/3. (PMID:28302723)
- Intellectual disability (HP:0001249): The term intellectual disability or intellectual developmental disorder is used to describe significantly sub-average intellectual and adaptive functioning based on clinical assessment and as measured by individually administered, appropriately normed, standardized and validated tests of intellectual functioning and adaptive behavior, with onset during the developmental period from infancy through adolescence. Evidence: PCS. Frequency: 3/3. (PMID:28302723)
- Cryptorchidism (HP:0000028): Testis in inguinal canal. That is, absence of one or both testes from the scrotum owing to failure of the testis or testes to descend through the inguinal canal to the scrotum. Evidence: TAS. (OMIM:300997)
- Frontal upsweep of hair (HP:0002236): Upward and/or sideward growth of anterior hair. Evidence: PCS. Frequency: 1/3. (PMID:28302723)
- Low-set ears (HP:0000369): Upper insertion of the ear to the scalp below an imaginary horizontal line drawn between the inner canthi of the eye and extending posteriorly to the ear. Evidence: PCS. Frequency: 2/2. (PMID:28584052)
These phenotypes are associated with the disease intellectual disability, X-linked 106 (OMIM:300997).